- Autosomal recessive inheritance (HP:0000007): A mode of inheritance that is observed for traits related to a gene encoded on one of the autosomes (i.e., the human chromosomes 1-22) in which a trait manifests in individuals with two pathogenic alleles, either homozygotes (two copies of the same mutant allele) or compound heterozygotes (whereby each copy of a gene has a distinct mutant allele). Evidence: IEA. (OMIM:243450)
- Anosmia (HP:0000458): An inability to perceive odors. This is a general term describing inability to smell arising in any part of the process of smelling from absorption of odorants into the nasal mucous overlying the olfactory epithelium, diffusion to the cilia, binding to olfactory receptor sites, generation of action potentials in olfactory neurons, and perception of a smell. Evidence: TAS. (OMIM:243450)
These phenotypes are associated with the disease isovaleric acid, inability to smell (OMIM:243450).